- Autosomal dominant inheritance (HP:0000006): A mode of inheritance that is observed for traits related to a gene encoded on one of the autosomes (i.e., the human chromosomes 1-22) in which a trait manifests in heterozygotes. In the context of medical genetics, an autosomal dominant disorder is caused when a single copy of the mutant allele is present. Males and females are affected equally, and can both transmit the disorder with a risk of 50% for each child of inheriting the mutant allele. Evidence: TAS. (OMIM:612643)
- Adult onset sensorineural hearing impairment (HP:0008615): The presence of sensorineural deafness with late onset. Evidence: TAS. (OMIM:612643)
These phenotypes are associated with the disease autosomal dominant nonsyndromic hearing loss 3B (OMIM:612643).